- Inguinal hernia (HP:0000023): Protrusion of the contents of the abdominal cavity through the inguinal canal. Evidence: TAS. Frequency: Frequent (HP:0040282). (ORPHA:2856)
- Cryptorchidism (HP:0000028): Testis in inguinal canal. That is, absence of one or both testes from the scrotum owing to failure of the testis or testes to descend through the inguinal canal to the scrotum. Evidence: TAS. Frequency: Very frequent (HP:0040281). (ORPHA:2856)
- Male pseudohermaphroditism (HP:0000037): Hermaphroditism refers to a discrepancy between the morphology of the gonads and that of the external genitalia. In male pseudohermaphroditism, the genotype is male (XY) and the external genitalia are imcompletely virilized, ambiguous, or complete female. If gonads are present, they are testes. Evidence: TAS. Frequency: Frequent (HP:0040282). (ORPHA:2856)
These phenotypes are associated with the disease Persistent Müllerian duct syndrome (ORPHA:2856).